- Joint hypermobility (HP:0001382): The capability that a joint (or a group of joints) has to move, passively and/or actively, beyond normal limits along physiological axes. Evidence: TAS. Frequency: Occasional (HP:0040283). (ORPHA:63442)
- Short middle phalanx of the 5th finger (HP:0004220): Hypoplastic/small middle phalanx of the fifth finger. Evidence: TAS. Frequency: Very frequent (HP:0040281). (ORPHA:63442)
- Short middle phalanx of finger (HP:0005819): Short (hypoplastic) middle phalanx of finger, affecting one or more fingers. Evidence: TAS. Frequency: Very frequent (HP:0040281). (ORPHA:63442)
- Abnormal epiphysis morphology (HP:0005930): An anomaly of epiphysis, which is the expanded articular end of a long bone that developes from a secondary ossification center, and which during the period of growth is either entirely cartilaginous or is separated from the shaft by a cartilaginous disk. Evidence: TAS. Frequency: Very frequent (HP:0040281). (ORPHA:63442)
- Short 1st metacarpal (HP:0010034): A developmental defect characterized by reduced length of the first metacarpal (long bone) of the hand. Evidence: TAS. Frequency: Very frequent (HP:0040281). (ORPHA:63442)
- Hypodontia (HP:0000668): The absence of five or less teeth from the normal series by a failure to develop. Evidence: TAS. Frequency: Frequent (HP:0040282). (ORPHA:63442)
- Delayed eruption of teeth (HP:0000684): Delayed tooth eruption, which can be defined as tooth eruption more than 2 SD beyond the mean eruption age. Evidence: TAS. Frequency: Frequent (HP:0040282). (ORPHA:63442)
- Hip dysplasia (HP:0001385): The presence of developmental dysplasia of the hip. Evidence: TAS. Frequency: Frequent (HP:0040282). (ORPHA:63442)
- Short stature (HP:0004322): A height below that which is expected according to age and gender norms. Although there is no universally accepted definition of short stature, many refer to "short stature" as height more than 2 standard deviations below the mean for age and gender (or below the 3rd percentile for age and gender dependent norms). Evidence: TAS. Frequency: Frequent (HP:0040282). (ORPHA:63442)
- Hip osteoarthritis (HP:0008843). Evidence: TAS. Frequency: Frequent (HP:0040282). (ORPHA:63442)
- Delayed skeletal maturation (HP:0002750): A decreased rate of skeletal maturation. Delayed skeletal maturation can be diagnosed on the basis of an estimation of the bone age from radiographs of specific bones in the human body. Evidence: TAS. Frequency: Occasional (HP:0040283). (ORPHA:63442)
These phenotypes are associated with the disease Angel-shaped phalango-epiphyseal dysplasia (ORPHA:63442).